Phenotypes associated with the disease cataract 23 (OMIM:610425):
- Nuclear cataract (HP:0100018): A nuclear cataract is an opacity or clouding that develops in the lens nucleus. That is, a nuclear cataract is one that is located in the center of the lens. The nucleus tends to darken changing from clear to yellow and sometimes brown. Evidence: PCS. Frequency: 2/2. Onset: Congenital onset (HP:0003577). (PMID:20577656)
- Microcornea (HP:0000482): A congenital abnormality of the cornea in which the cornea and the anterior segment of the eye are smaller than normal. The horizontal diameter of the cornea does not reach 10 mm even in adulthood. Evidence: PCS. Frequency: 2/2. (PMID:20577656)
- Lamellar cataract (HP:0007971): A congenital cataract in which opacity is limited to layers of the lens external to the nucleus (i.e., the perinuclear region), i.e., between the nuclear and cortical layers of the lens. Evidence: PCS. Onset: Childhood onset (HP:0011463). (PMID:16960806)
- Autosomal dominant inheritance (HP:0000006): A mode of inheritance that is observed for traits related to a gene encoded on one of the autosomes (i.e., the human chromosomes 1-22) in which a trait manifests in heterozygotes. In the context of medical genetics, an autosomal dominant disorder is caused when a single copy of the mutant allele is present. Males and females are affected equally, and can both transmit the disorder with a risk of 50% for each child of inheriting the mutant allele. Evidence: PCS. (PMID:16960806)